- Microangiopathic hemolytic anemia (HP:0001937). Evidence: IEA. (OMIM:141000)
- Hyperkalemia (HP:0002153): The concentration of potassium(1+) in the blood circulation is above the upper limit of normal. Evidence: IEA. (OMIM:141000)
- Ventricular arrhythmia (HP:0004308). Evidence: IEA. (OMIM:141000)
- Thrombocytopenia (HP:0001873): A reduction in the number of circulating thrombocytes. Evidence: IEA. (OMIM:141000)
- Autosomal dominant inheritance (HP:0000006): A mode of inheritance that is observed for traits related to a gene encoded on one of the autosomes (i.e., the human chromosomes 1-22) in which a trait manifests in heterozygotes. In the context of medical genetics, an autosomal dominant disorder is caused when a single copy of the mutant allele is present. Males and females are affected equally, and can both transmit the disorder with a risk of 50% for each child of inheriting the mutant allele. Evidence: IEA. (OMIM:141000)
- Hemangioma (HP:0001028): A hemangioma is a benign tumor characterized by blood-filled spaces lined by benign endothelial cells. A hemangioma characterized by large endothelial spaces (caverns) is called a cavernous hemangioma (in contrast to a hemangioma with small endothelial spaces, which is called capillary hemangioma). Evidence: IEA. (OMIM:141000)
These phenotypes are associated with the disease Kasabach-Merritt syndrome (OMIM:141000).